Phenotypes associated with the disease Ichthyosis-hypotrichosis syndrome (ORPHA:91132):
- Ichthyosis (HP:0008064): An abnormality of the skin characterized the presence of excessive amounts of dry surface scales on the skin resulting from an abnormality of keratinization. Evidence: TAS. Frequency: Very frequent (HP:0040281). (ORPHA:91132)
- Sparse hair (HP:0008070): Reduced density of hairs. Evidence: TAS. Frequency: Very frequent (HP:0040281). (ORPHA:91132)